- Reticular pigmentary degeneration (HP:0007937): A pattern of peripheral netlike retinal pigmentation that forms a polygonal arrangement of hyperpigmented lines forming geometric patterns in the fundus. Evidence: TAS. (OMIM:126600)
- Visual impairment (HP:0000505): Visual impairment (or vision impairment) is vision loss (of a person) to such a degree as to qualify as an additional support need through a significant limitation of visual capability resulting from either disease, trauma, or congenital or degenerative conditions that cannot be corrected by conventional means, such as refractive correction, medication, or surgery. Evidence: TAS. (OMIM:126600)
- Autosomal dominant inheritance (HP:0000006): A mode of inheritance that is observed for traits related to a gene encoded on one of the autosomes (i.e., the human chromosomes 1-22) in which a trait manifests in heterozygotes. In the context of medical genetics, an autosomal dominant disorder is caused when a single copy of the mutant allele is present. Males and females are affected equally, and can both transmit the disorder with a risk of 50% for each child of inheriting the mutant allele. Evidence: TAS. (OMIM:126600)
- Retinal dystrophy (HP:0000556): Retinal dystrophy is an abnormality of the retina associated with a hereditary process. Retinal dystrophies are defined by their predominantly monogenic inheritance and they are frequently associated with loss or dysfunction of photoreceptor cells as a primary or secondary event. Evidence: TAS. (OMIM:126600)
These phenotypes are associated with the disease Doyne honeycomb retinal dystrophy (OMIM:126600).